- Visual loss (HP:0000572): Loss of visual acuity (implying that vision was better at a certain time point in life). Otherwise the term reduced visual acuity should be used (or a subclass of that). Evidence: TAS. Frequency: Very frequent (HP:0040281). (ORPHA:209959)
- Ocular pain (HP:0200026): An unpleasant sensation characterized by physical discomfort (such as pricking, throbbing, or aching) localized to the eye. Evidence: TAS. Frequency: Very frequent (HP:0040281). (ORPHA:209959)
- Pseudophakia (HP:0500081): The term pseudophakia refers to having an artificial lens implanted after the natural eye lens has been removed. During cataract surgery the natural cloudy lens is replaced by an pseudophakia intraocular lens (IOL). Evidence: TAS. Frequency: Very frequent (HP:0040281). (ORPHA:209959)
- Keratitis (HP:0000491): Inflammation of the cornea. Evidence: TAS. Frequency: Frequent (HP:0040282). (ORPHA:209959)
- Photophobia (HP:0000613): Excessive sensitivity to light with the sensation of discomfort or pain in the eyes due to exposure to bright light. Evidence: TAS. Frequency: Frequent (HP:0040282). (ORPHA:209959)
- Abnormal pupil morphology (HP:0000615): An abnormality of the pupil. Evidence: TAS. Frequency: Frequent (HP:0040282). (ORPHA:209959)
- Blurred vision (HP:0000622): Lack of sharpness of vision resulting in the inability to see fine detail. Evidence: TAS. Frequency: Frequent (HP:0040282). (ORPHA:209959)
- Vitreoretinopathy (HP:0007773): Ocular abnormality characterized by premature degeneration of the vitreous and the retina that may be associated with increased risk of retinal detachment. Evidence: TAS. Frequency: Frequent (HP:0040282). (ORPHA:209959)
- Abnormal corneal endothelium morphology (HP:0011488): Abnormality of the corneal endothelium, that is, the single layer of cells on the inner surface of the cornea. Evidence: TAS. Frequency: Frequent (HP:0040282). (ORPHA:209959)
- Anterior uveitis (HP:0012122): Inflammation of the uveal tract in which the primary site of inflammation is the anterior chamber. Evidence: TAS. Frequency: Frequent (HP:0040282). (ORPHA:209959)
- Posterior uveitis (HP:0012123): Inflammation of the uveal tract in which the primary site of inflammation is the retina or choroid. Evidence: TAS. Frequency: Frequent (HP:0040282). (ORPHA:209959)
- Red eye (HP:0025337): A reddish appearance over the white part (sclera) of the eye ranging from a few enlarged blood vessels appearing as wiggly lines over the sclera to a bright red color completely covering to sclera. Evidence: TAS. Frequency: Frequent (HP:0040282). (ORPHA:209959)
- Conjunctival hyperemia (HP:0030953): Dilatation of the blood vessels of the conjunctiva leading to a red appearance of the sclera. Evidence: TAS. Frequency: Frequent (HP:0040282). (ORPHA:209959)
- Abnormal vitreous humor morphology (HP:0004327): Any structural anomaly of the vitreous body. Evidence: TAS. Frequency: Occasional (HP:0040283). (ORPHA:209959)
- Ocular hypertension (HP:0007906): Intraocular pressure that is 2 standard deviations above the population mean. Evidence: TAS. Frequency: Occasional (HP:0040283). (ORPHA:209959)
- Tractional retinal detachment (HP:0007917): A type of retinal detachment arising due to a combination of contracting retinal membranes, abnormal vitreoretinal adhesions, and vitreous changes, in the absence of a full-thickness retinal defect. Evidence: TAS. Frequency: Occasional (HP:0040283). (ORPHA:209959)
- Retinal arteritis (HP:0008030). Evidence: TAS. Frequency: Occasional (HP:0040283). (ORPHA:209959)
- Posterior synechiae of the anterior chamber (HP:0011484): Adhesions between the iris and the lens. Evidence: TAS. Frequency: Occasional (HP:0040283). (ORPHA:209959)
- Cystoid macular edema (HP:0011505): Cystoid thickening of the retina that takes place due to accumulation of extracellular fluid in the macula as a nonspecific response to blood-retinal barrier breakdown. Histological studies show that radially orientated cystoid spaces consisting of ophthalmoscopically clear fluid are often clinically detectable in the macula area. Evidence: TAS. Frequency: Occasional (HP:0040283). (ORPHA:209959)
- Vitritis (HP:0011531): Inflammation of the vitreous body, characterized by the presence of inflammatory cells and protein exudate in the vitreous cavity. Evidence: TAS. Frequency: Occasional (HP:0040283). (ORPHA:209959)
- Hyphema (HP:0011886): Bleeding in the anterior chamber of the eye. Evidence: TAS. Frequency: Occasional (HP:0040283). (ORPHA:209959)
- Corneal stromal edema (HP:0012040): Abnormal accumulation of fluid and swelling of the stroma of cornea. Evidence: TAS. Frequency: Occasional (HP:0040283). (ORPHA:209959)
- Panuveitis (HP:0012121): Inflammation of the uveal tract in which inflammation affects the anterior chamber, vitreous, retina or choroid. Evidence: TAS. Frequency: Occasional (HP:0040283). (ORPHA:209959)
- Corneal keratic precipitates (HP:0025341): An inflammatory cellular deposit deposited on the corneal endothelium and visible as spots on the cornea. Evidence: TAS. Frequency: Occasional (HP:0040283). (ORPHA:209959)
- Anterior chamber cells grade 1+ (HP:0025561): Anterior chamber cells with 6-15 cells in a 1 mm by 1 mm slit beam field, employing adequate light intensity and magnification on a slit lamp. Evidence: TAS. Frequency: Occasional (HP:0040283). (ORPHA:209959)
- Abnormal amplitude of pattern electroretinogram (HP:0030485). Evidence: TAS. Frequency: Occasional (HP:0040283). (ORPHA:209959)
- Abnormal timing of pattern electroretinogram (HP:0030486). Evidence: TAS. Frequency: Occasional (HP:0040283). (ORPHA:209959)
- Hypopyon (HP:0031615): Presence of pus (appears as a white fluid) producing a fluid level in the inferior part of the anterior chamber. Evidence: TAS. Frequency: Occasional (HP:0040283). (ORPHA:209959)
- Anterior chamber flare grade 1+ (HP:0031618): Faint anterior chamber flare. Evidence: TAS. Frequency: Occasional (HP:0040283). (ORPHA:209959)
- Macular edema (HP:0040049): Thickening of the retina that takes place due to accumulation of extracellular fluid in the macula as a nonspecific response to blood-retinal barrier breakdown. It can either have a cystoid aspect in the fovea, or a more diffuse aspect. Evidence: TAS. Frequency: Occasional (HP:0040283). (ORPHA:209959)
These phenotypes are associated with the disease Phacoanaphylactic uveitis (ORPHA:209959).